Phenotypes associated with the disease Non-specific autoimmune supratentorial encephalitis with characteristic antibodies (ORPHA:624166):
- Anti-dachshund family transcription factor 1 antibody positivity (HP:6000877): The presence of autoantibodies in the serum that react against dachshund-homolog 1 (DACH1) autoantigen. Evidence: TAS. Frequency: Frequent (HP:0040282). (ORPHA:624166)
- Anti-potassium channel tetramerization domain containing 16 antibody positivity (HP:6000878): The presence of autoantibodies (immunoglobulins) in the blood circulation that react against potassium channel tetramerization domain containing 16 (KCTD16). Evidence: TAS. Frequency: Frequent (HP:0040282). (ORPHA:624166)
- Anti-DREBRIN antibody positivity (HP:6001059): The presence of autoantibodies in the serum that react against dendritic spine scaffolding protein Drebrin. Evidence: TAS. Frequency: Frequent (HP:0040282). (ORPHA:624166)